Phenotypes associated with the disease Lateral meningocele syndrome (ORPHA:2789):
- Joint hypermobility (HP:0001382): The capability that a joint (or a group of joints) has to move, passively and/or actively, beyond normal limits along physiological axes. Evidence: TAS. Frequency: Frequent (HP:0040282). (ORPHA:2789)
- Dolichocephaly (HP:0000268): An abnormality of skull shape characterized by a increased anterior-posterior diameter, i.e., an increased antero-posterior dimension of the skull. Cephalic index less than 76%. Alternatively, an apparently increased antero-posterior length of the head compared to width. Often due to premature closure of the sagittal suture. Evidence: TAS. Frequency: Very frequent (HP:0040281). (ORPHA:2789)
- Malar flattening (HP:0000272): Underdevelopment of the malar prominence of the jugal bone (zygomatic bone in mammals), appreciated in profile, frontal view, and/or by palpation. Evidence: TAS. Frequency: Very frequent (HP:0040281). (ORPHA:2789)
- Narrow face (HP:0000275): Bizygomatic (upper face) and bigonial (lower face) width are both more than 2 standard deviations below the mean (objective); or, an apparent reduction in the width of the upper and lower face (subjective). Evidence: TAS. Frequency: Very frequent (HP:0040281). (ORPHA:2789)
- Micrognathia (HP:0000347): Developmental hypoplasia of the mandible. Evidence: TAS. Frequency: Very frequent (HP:0040281). (ORPHA:2789)
- Posteriorly rotated ears (HP:0000358): A type of abnormal location of the ears in which the position of the ears is characterized by posterior rotation (the superior part of the ears is rotated towards the back of the head, and the inferior part of the ears towards the front). Evidence: TAS. Frequency: Very frequent (HP:0040281). (ORPHA:2789)
- Low-set ears (HP:0000369): Upper insertion of the ear to the scalp below an imaginary horizontal line drawn between the inner canthi of the eye and extending posteriorly to the ear. Evidence: TAS. Frequency: Very frequent (HP:0040281). (ORPHA:2789)
- Conductive hearing impairment (HP:0000405): An abnormality of vibrational conductance of sound to the inner ear leading to impairment of sensory perception of sound. Evidence: TAS. Frequency: Very frequent (HP:0040281). (ORPHA:2789)
- Atresia of the external auditory canal (HP:0000413): Absence or failure to form of the external auditory canal. Evidence: TAS. Frequency: Very frequent (HP:0040281). (ORPHA:2789)
- Downslanted palpebral fissures (HP:0000494): The palpebral fissure inclination is more than two standard deviations below the mean. Evidence: TAS. Frequency: Very frequent (HP:0040281). (ORPHA:2789)
- Ptosis (HP:0000508): The upper eyelid margin is positioned 3 mm or more lower than usual and covers the superior portion of the iris (objective); or, the upper lid margin obscures at least part of the pupil (subjective). Evidence: TAS. Frequency: Very frequent (HP:0040281). (ORPHA:2789)
- Meningocele (HP:0002435): Protrusion of the meninges through a defect of the skull or vertebral column. Evidence: TAS. Frequency: Very frequent (HP:0040281). (ORPHA:2789)
- Wormian bones (HP:0002645): The presence of extra bones within a cranial suture. Wormian bones are irregular isolated bones which appear in addition to the usual centers of ossification of the cranium. Evidence: TAS. Frequency: Very frequent (HP:0040281). (ORPHA:2789)
- High, narrow palate (HP:0002705): The presence of a high and narrow palate. Evidence: TAS. Frequency: Very frequent (HP:0040281). (ORPHA:2789)
- Dural ectasia (HP:0100775): A widening or ballooning of the dural sac surrounding the spinal cord usually at the lumbosacral level. Evidence: TAS. Frequency: Very frequent (HP:0040281). (ORPHA:2789)
- Inguinal hernia (HP:0000023): Protrusion of the contents of the abdominal cavity through the inguinal canal. Evidence: TAS. Frequency: Frequent (HP:0040282). (ORPHA:2789)
- Smooth philtrum (HP:0000319): Flat skin surface, with no ridge formation in the central region of the upper lip between the nasal base and upper vermilion border. Evidence: TAS. Frequency: Frequent (HP:0040282). (ORPHA:2789)
- Short neck (HP:0000470): Diminished length of the neck. Evidence: TAS. Frequency: Frequent (HP:0040282). (ORPHA:2789)
- Dental crowding (HP:0000678): Changes in alignment of teeth in the dental arch. Evidence: TAS. Frequency: Frequent (HP:0040282). (ORPHA:2789)
- Pectus excavatum (HP:0000767): A defect of the chest wall characterized by a depression of the sternum, giving the chest ("pectus") a caved-in ("excavatum") appearance. Evidence: TAS. Frequency: Frequent (HP:0040282). (ORPHA:2789)
- Umbilical hernia (HP:0001537): Protrusion of abdominal contents through a defect in the abdominal wall musculature around the umbilicus. Skin and subcutaneous tissue overlie the defect. Evidence: TAS. Frequency: Frequent (HP:0040282). (ORPHA:2789)
- Low posterior hairline (HP:0002162): Hair on the neck extends more inferiorly than usual. Evidence: TAS. Frequency: Frequent (HP:0040282). (ORPHA:2789)
- Scoliosis (HP:0002650): The presence of an abnormal lateral curvature of the spine. Evidence: TAS. Frequency: Frequent (HP:0040282). (ORPHA:2789)
- Abnormal vertebral body morphology (HP:0003312): Abnormal form of vertebral body, which is the central cylindrical portion of the vertebra that together with other structures such as the vertebral arch, pedicles, laminae, spinous process, transverse processes, and articular facets makes up a vertebra. Evidence: TAS. Frequency: Frequent (HP:0040282). (ORPHA:2789)
- Abnormality of the middle ear ossicles (HP:0004452): An abnormality of the middle-ear ossicles (three small bones called malleus, incus, and stapes) that are contained within the middle ear and serve to transmit sounds from the air to the fluid-filled labyrinth (cochlea). Evidence: TAS. Frequency: Frequent (HP:0040282). (ORPHA:2789)
- Craniofacial hyperostosis (HP:0004493): Excessive growth of the craniofacial bones. Evidence: TAS. Frequency: Frequent (HP:0040282). (ORPHA:2789)
- Prominent metopic ridge (HP:0005487): Vertical bony ridge positioned in the midline of the forehead. Evidence: TAS. Frequency: Frequent (HP:0040282). (ORPHA:2789)
- Cryptorchidism (HP:0000028): Testis in inguinal canal. That is, absence of one or both testes from the scrotum owing to failure of the testis or testes to descend through the inguinal canal to the scrotum. Evidence: TAS. Frequency: Occasional (HP:0040283). (ORPHA:2789)
- High palate (HP:0000218): Height of the palate more than 2 SD above the mean (objective) or palatal height at the level of the first permanent molar more than twice the height of the teeth (subjective). Evidence: TAS. Frequency: Occasional (HP:0040283). (ORPHA:2789)
- Epicanthus (HP:0000286): A fold of skin starting above the medial aspect of the upper eyelid and arching downward to cover, pass in front of and lateral to the medial canthus. Evidence: TAS. Frequency: Occasional (HP:0040283). (ORPHA:2789)
- Hypertelorism (HP:0000316): Interpupillary distance more than 2 SD above the mean (alternatively, the appearance of an increased interpupillary distance or widely spaced eyes). Evidence: TAS. Frequency: Occasional (HP:0040283). (ORPHA:2789)
- Sensorineural hearing impairment (HP:0000407): A type of hearing impairment in one or both ears related to an abnormal functionality of the cochlear nerve. Evidence: TAS. Frequency: Occasional (HP:0040283). (ORPHA:2789)
- Proptosis (HP:0000520): An eye that is protruding anterior to the plane of the face to a greater extent than is typical. Evidence: TAS. Frequency: Occasional (HP:0040283). (ORPHA:2789)
- Iris coloboma (HP:0000612): A coloboma of the iris. Evidence: TAS. Frequency: Occasional (HP:0040283). (ORPHA:2789)
- Hypotonia (HP:0001252): Hypotonia is an abnormally low muscle tone (the amount of tension or resistance to movement in a muscle). Even when relaxed, muscles have a continuous and passive partial contraction which provides some resistance to passive stretching. Hypotonia thus manifests as diminished resistance to passive stretching. Hypotonia is not the same as muscle weakness, although the two conditions can co-exist. Evidence: TAS. Frequency: Occasional (HP:0040283). (ORPHA:2789)
- Global developmental delay (HP:0001263): A delay in the achievement of motor or mental milestones in the domains of development of a child, including motor skills, speech and language, cognitive skills, and social and emotional skills. This term should only be used to describe children younger than five years of age. Evidence: TAS. Frequency: Occasional (HP:0040283). (ORPHA:2789)
- Ventricular septal defect (HP:0001629): A hole between the two bottom chambers (ventricles) of the heart. The defect is centered around the most superior aspect of the ventricular septum. Evidence: TAS. Frequency: Occasional (HP:0040283). (ORPHA:2789)
- Chiari malformation (HP:0002308): Chiari malformation consists of a downward displacement of the cerebellar tonsils and the medulla through the foramen magnum, sometimes causing hydrocephalus as a result of obstruction of CSF outflow. Evidence: TAS. Frequency: Occasional (HP:0040283). (ORPHA:2789)
- Kyphosis (HP:0002808): Exaggerated anterior convexity of the thoracic vertebral column. Evidence: TAS. Frequency: Occasional (HP:0040283). (ORPHA:2789)
- Hyperlordosis (HP:0003307): Abnormally increased curvature (anterior concavity) of the lumbar or cervical spine. Evidence: TAS. Frequency: Occasional (HP:0040283). (ORPHA:2789)
- Syringomyelia (HP:0003396): Dilated, glial-lined cavity in spinal cord. This cavity does not communicate with the central canal, and usually is between the dorsal columns unilaterally or bilaterally along the side of the cord. Evidence: TAS. Frequency: Occasional (HP:0040283). (ORPHA:2789)